Phenotypes associated with the disease autosomal dominant nonsyndromic hearing loss 21 (OMIM:607017):
- Congenital onset (HP:0003577): A phenotypic abnormality that is present at birth. Evidence: PCS. Frequency: 1/41. (PMID:32631815)
- Juvenile onset (HP:0003621): Onset of signs or symptoms of disease between the age of 5 and 15 years. Evidence: PCS. Frequency: 8/41. (PMID:32631815)
- Middle age onset (HP:0003596): A type of adult onset with onset of symptoms at the age of 40 to 60 years. Evidence: PCS. Frequency: 10/41. (PMID:32631815)
- Sensorineural hearing impairment (HP:0000407): A type of hearing impairment in one or both ears related to an abnormal functionality of the cochlear nerve. Evidence: PCS. (PMID:32631815)
- Childhood onset (HP:0011463): Onset of disease at the age of between 1 and 5 years. Evidence: PCS. Frequency: 2/41. (PMID:32631815)
- Young adult onset (HP:0011462): Onset of disease at the age of between 16 and 40 years. Evidence: PCS. Frequency: 19/41. (PMID:32631815)
- Autosomal dominant inheritance (HP:0000006): A mode of inheritance that is observed for traits related to a gene encoded on one of the autosomes (i.e., the human chromosomes 1-22) in which a trait manifests in heterozygotes. In the context of medical genetics, an autosomal dominant disorder is caused when a single copy of the mutant allele is present. Males and females are affected equally, and can both transmit the disorder with a risk of 50% for each child of inheriting the mutant allele. Evidence: PCS. (PMID:32631815)
- Neonatal onset (HP:0003623): Onset of signs or symptoms of disease within the first 28 days of life. Evidence: PCS. Frequency: 1/41. (PMID:32631815)